Phenotypes associated with the disease Immunoglobulin A nephropathy (ORPHA:34145):
- IgA deposition in the glomerulus (HP:0000794): The presence of immunoglobulin A deposits in the glomerulus. Evidence: TAS. Frequency: Frequent (HP:0040282). (ORPHA:34145)
- Acute kidney injury (HP:0001919): Sudden loss of renal function, as manifested by decreased urine production, and a rise in serum creatinine or blood urea nitrogen concentration (azotemia). Evidence: TAS. Frequency: Frequent (HP:0040282). (ORPHA:34145)
- Microscopic hematuria (HP:0002907): Microscopic hematuria detected by dipstick or microscopic examination of the urine. Evidence: TAS. Frequency: Frequent (HP:0040282). (ORPHA:34145)
- Macroscopic hematuria (HP:0012587): Hematuria that is visible upon inspection of the urine. Evidence: TAS. Frequency: Frequent (HP:0040282). (ORPHA:34145)
- Mild proteinuria (HP:0012595): Mildly increased levels of protein in the urine (150-500 mg per day in adults). Evidence: TAS. Frequency: Frequent (HP:0040282). (ORPHA:34145)
- Renal insufficiency (HP:0000083): A reduction in the level of performance of the kidneys in areas of function comprising the concentration of urine, removal of wastes, the maintenance of electrolyte balance, homeostasis of blood pressure, and calcium metabolism. Evidence: TAS. Frequency: Occasional (HP:0040283). (ORPHA:34145)
- Glomerulonephritis (HP:0000099): Inflammation of the renal glomeruli. Evidence: TAS. Frequency: Occasional (HP:0040283). (ORPHA:34145)
- Facial edema (HP:0000282). Evidence: TAS. Frequency: Occasional (HP:0040283). (ORPHA:34145)
- Hypertension (HP:0000822): The presence of chronic increased pressure in the systemic arterial system. Evidence: TAS. Frequency: Occasional (HP:0040283). (ORPHA:34145)
- Cirrhosis (HP:0001394): A chronic disorder of the liver in which liver tissue becomes scarred and is partially replaced by regenerative nodules and fibrotic tissue resulting in loss of liver function. Evidence: TAS. Frequency: Occasional (HP:0040283). (ORPHA:34145)
- Ascites (HP:0001541): Accumulation of fluid in the peritoneal cavity (between the layers of the peritoneum that lines the abdomen). Evidence: TAS. Frequency: Occasional (HP:0040283). (ORPHA:34145)
- Celiac disease (HP:0002608): Celiac disease (CD) is an autoimmune condition affecting the small intestine, triggered by the ingestion of gluten, the protein fraction of wheat, barley, and rye. Clinical manifestations of CD are highly variable and include both gastrointestinal and non-gastrointestinal features. The hallmark of CD is an immune-mediated enteropathy. This term is included because the occurrence of CD is seen as a feature of a number of other diseases. Evidence: TAS. Frequency: Occasional (HP:0040283). (ORPHA:34145)
- Increased circulating IgA concentration (HP:0003261): An abnormally increased level of immunoglobulin A in blood. Evidence: TAS. Frequency: Occasional (HP:0040283). (ORPHA:34145)
- Crackles (HP:0030830): Crackles are discontinuous, explosive, and nonmusical adventitious lung sounds normally heard in inspiration and sometimes during expiration. Crackles are usually classified as fine and coarse crackles based on their duration, loudness, pitch, timing in the respiratory cycle, and relationship to coughing and changing body position. Evidence: TAS. Frequency: Occasional (HP:0040283). (ORPHA:34145)
- Foamy urine (HP:0031504): Urine has an increased amount of frothy fine bubbles. Evidence: TAS. Frequency: Occasional (HP:0040283). (ORPHA:34145)
- Glomerular crescent formation (HP:0033316): Glomerular crescent refers hyperplastic lesions involving 10% or more of the circumference of Bowman's capsule. Crescents can be composed of a variable mixture of epithelial/leukocyte hypercellularity, fibrous matrix, and fibrin. Evidence: TAS. Frequency: Occasional (HP:0040283). (ORPHA:34145)
- Nephrotic range proteinuria (HP:0012593): Severely increased amount of excretion of protein in the urine, defined as 3.5 grams per day or more in adults and 40 mg per meter-squared body surface area per hour in children. Evidence: TAS. Frequency: Very rare (HP:0040284). (ORPHA:34145)